- Middle age onset (HP:0003596): A type of adult onset with onset of symptoms at the age of 40 to 60 years. Evidence: PCS. Frequency: 1/1. (PMID:17245405)
- Paroxysmal atrial fibrillation (HP:0004757): Episodes of atrial fibrillation that typically last for several hours up to one day and terminate spontaneously. Evidence: PCS. Frequency: 1/1. (PMID:17245405)
- Autosomal dominant inheritance (HP:0000006): A mode of inheritance that is observed for traits related to a gene encoded on one of the autosomes (i.e., the human chromosomes 1-22) in which a trait manifests in heterozygotes. In the context of medical genetics, an autosomal dominant disorder is caused when a single copy of the mutant allele is present. Males and females are affected equally, and can both transmit the disorder with a risk of 50% for each child of inheriting the mutant allele. Evidence: PCS. (PMID:17245405)
These phenotypes are associated with the disease atrial fibrillation, familial, 12 (OMIM:614050).